Phenotypes associated with the disease attention deficit-hyperactivity disorder 8 (OMIM:619957):
- Childhood onset (HP:0011463): Onset of disease at the age of between 1 and 5 years. Evidence: PCS. Frequency: 3/3. (PMID:34702855)
- Mild global developmental delay (HP:0011342): A mild delay in the achievement of motor or mental milestones in the domains of development of a child. Evidence: PCS. Frequency: 1/3. (PMID:34702855)
- Autosomal recessive inheritance (HP:0000007): A mode of inheritance that is observed for traits related to a gene encoded on one of the autosomes (i.e., the human chromosomes 1-22) in which a trait manifests in individuals with two pathogenic alleles, either homozygotes (two copies of the same mutant allele) or compound heterozygotes (whereby each copy of a gene has a distinct mutant allele). Evidence: PCS. (PMID:34702855)
- Attention deficit hyperactivity disorder (HP:0007018): Attention deficit hyperactivity disorder (ADHD) manifests at age 2-3 years or by first grade at the latest. The main symptoms are distractibility, impulsivity, hyperactivity, and often trouble organizing tasks and projects, difficulty going to sleep, and social problems from being aggressive, loud, or impatient. Evidence: PCS. Frequency: 3/3. Onset: Childhood onset (HP:0011463). (PMID:34702855)